Phenotypes associated with the disease immunoglobulin d level in plasma, low (OMIM:242890):
- Abnormality of the immune system (HP:0002715): An abnormality of the immune system. Evidence: IEA. (OMIM:242890)
- Autosomal recessive inheritance (HP:0000007): A mode of inheritance that is observed for traits related to a gene encoded on one of the autosomes (i.e., the human chromosomes 1-22) in which a trait manifests in individuals with two pathogenic alleles, either homozygotes (two copies of the same mutant allele) or compound heterozygotes (whereby each copy of a gene has a distinct mutant allele). Evidence: IEA. (OMIM:242890)